- Decreased body weight (HP:0004325): Abnormally low body weight. Evidence: PCS. Frequency: 1/1. (PMID:30046013)
- Brachydactyly (HP:0001156): Digits that appear disproportionately short compared to the hand/foot. The word brachydactyly is used here to describe a series distinct patterns of shortened digits (brachydactyly types A-E). This is the sense used here. Evidence: PCS. Frequency: 1/1. (PMID:30046013)
- Short stature (HP:0004322): A height below that which is expected according to age and gender norms. Although there is no universally accepted definition of short stature, many refer to "short stature" as height more than 2 standard deviations below the mean for age and gender (or below the 3rd percentile for age and gender dependent norms). Evidence: PCS. Frequency: 1/1. (PMID:30046013)
- Inguinal hernia (HP:0000023): Protrusion of the contents of the abdominal cavity through the inguinal canal. Evidence: PCS. Frequency: 1/1. (PMID:30046013)
- Infantile onset (HP:0003593): Onset of signs or symptoms of disease between 28 days to one year of life. Evidence: PCS. Frequency: 1/1. (PMID:30046013)
- Delayed gross motor development (HP:0002194): A type of motor delay characterized by a delay in acquiring the ability to control the large muscles of the body for walking, running, sitting, and crawling. Evidence: PCS. Frequency: 1/1. (PMID:30046013)
- Short femoral neck (HP:0100864): An abnormally short femoral neck (which is the process of bone, connecting the femoral head with the femoral shaft). Evidence: PCS. Frequency: 1/1. (PMID:30046013)
- Elevated circulating beta-glucuronidase activity (HP:6000819): The activity of beta-glucuronidase (EC 3.2.1.31) in the blood circulation is above the upper limit of normal. Evidence: PCS. Frequency: 1/1. (PMID:30046013)
- Cataract (HP:0000518): A cataract is an opacity or clouding that develops in the crystalline lens of the eye or in its capsule. Evidence: PCS. Frequency: 1/1. Onset: Infantile onset (HP:0003593). (PMID:30046013)
- Kyphosis (HP:0002808): Exaggerated anterior convexity of the thoracic vertebral column. Evidence: PCS. Frequency: 1/1. (PMID:30046013)
- Small for gestational age (HP:0001518): Smaller than normal size according to sex and gestational age related norms, defined as a weight below the 10th percentile for the gestational age. Evidence: PCS. Frequency: 1/1. Onset: Congenital onset (HP:0003577). (PMID:30046013)
- Prominent forehead (HP:0011220): Forward prominence of the entire forehead, due to protrusion of the frontal bone. Evidence: PCS. Frequency: 1/1. (PMID:30046013)
- Autosomal recessive inheritance (HP:0000007): A mode of inheritance that is observed for traits related to a gene encoded on one of the autosomes (i.e., the human chromosomes 1-22) in which a trait manifests in individuals with two pathogenic alleles, either homozygotes (two copies of the same mutant allele) or compound heterozygotes (whereby each copy of a gene has a distinct mutant allele). Evidence: PCS. (PMID:30046013)
- Waddling gait (HP:0002515): Weakness of the hip girdle and upper thigh muscles, for instance in myopathies, leads to an instability of the pelvis on standing and walking. If the muscles extending the hip joint are affected, the posture in that joint becomes flexed and lumbar lordosis increases. The patients usually have difficulties standing up from a sitting position. Due to weakness in the gluteus medius muscle, the hip on the side of the swinging leg drops with each step (referred to as Trendelenburg sign). The gait appears waddling. The patients frequently attempt to counteract the dropping of the hip on the swinging side by bending the trunk towards the side which is in the stance phase (in the German language literature this is referred to as Duchenne sign). Similar gait patterns can be caused by orthopedic conditions when the origin and the insertion site of the gluteus medius muscle are closer to each other than normal, for instance due to a posttraumatic elevation of the trochanter or pseudarthrosis of the femoral neck. Evidence: PCS. Frequency: 1/1. (PMID:30046013)
- Pectus carinatum (HP:0000768): A deformity of the chest caused by overgrowth of the ribs and characterized by protrusion of the sternum. Evidence: PCS. Frequency: 1/1. (PMID:30046013)
- Macrotia (HP:0000400): Median longitudinal ear length greater than two standard deviations above the mean and median ear width greater than two standard deviations above the mean (objective); or, apparent increase in length and width of the pinna (subjective). Evidence: PCS. Frequency: 1/1. (PMID:30046013)
- Delayed ossification of carpal bones (HP:0001216): Ossification of carpal bones occurs later than age-adjusted norms. Evidence: PCS. Frequency: 1/1. (PMID:30046013)
- Posteriorly rotated ears (HP:0000358): A type of abnormal location of the ears in which the position of the ears is characterized by posterior rotation (the superior part of the ears is rotated towards the back of the head, and the inferior part of the ears towards the front). Evidence: PCS. Frequency: 1/1. (PMID:30046013)
- Reduced bone mineral density (HP:0004349): A reduction of bone mineral density, that is, of the amount of matter per cubic centimeter of bones. Evidence: PCS. Frequency: 1/1. (PMID:30046013)
- Spondyloepiphyseal dysplasia (HP:0002655): A disorder of bone growth affecting the vertebrae and the ends of the long bones (epiphyses). Evidence: PCS. Frequency: 1/1. (PMID:30046013)
These phenotypes are associated with the disease spondyloepiphyseal dysplasia, kondo-fu type (OMIM:618392).